Phenotypes associated with the disease Isolated epispadias (ORPHA:93928):
- Displacement of the urethral meatus (HP:0100627): A displacement of the external urethral orifice from its normal position (in males normally placed at the tip of glans penis, in females normally placed about 2.5 cm behind the glans clitoridis and immediately in front of that of the vagina). Evidence: TAS. Frequency: Very frequent (HP:0040281). (ORPHA:93928)
- Epispadias (HP:0000039): Epispadias is a urogenital malformation characterized by the failure of the urethral tube to tubularize on the dorsal aspect. Unlike in hypospadias, where the meatus is on the ventral aspect, children with epispadias have a wide-open urethral plate on the dorsum. It is commonly seen as a component in the spectrum of bladder exstrophy-epispadias-complex. Isolated epispadias constitutes less than 10 percent of the total cases of epispadias. Evidence: TAS. Frequency: Very frequent (HP:0040281). (ORPHA:93928)
- Urinary incontinence (HP:0000020): Loss of the ability to control the urinary bladder leading to involuntary urination. Evidence: TAS. Frequency: Frequent (HP:0040282). (ORPHA:93928)
- Vesicoureteral reflux (HP:0000076): Abnormal (retrograde) movement of urine from the bladder into ureters or kidneys related to inadequacy of the valvular mechanism at the ureterovesicular junction or other causes. Evidence: TAS. Frequency: Frequent (HP:0040282). (ORPHA:93928)
- Abnormal pelvic girdle bone morphology (HP:0002644): An abnormality of the bony pelvic girdle, which is a ring of bones connecting the vertebral column to the femurs. Evidence: TAS. Frequency: Frequent (HP:0040282). (ORPHA:93928)
- Bifid clitoris (HP:0030911): Two clitorides located side by side. Evidence: TAS. Frequency: Occasional (HP:0040283). (ORPHA:93928)